- Bimanual synkinesia (HP:0001335): Involuntary movements of one hand that accompany and mirror intentional movements of the opposite hand. Evidence: TAS. Frequency: Frequent (HP:0040282). (ORPHA:238722)
- Clumsiness (HP:0002312): Lack of physical coordination resulting in an abnormal tendency to drop items or bump into objects. Evidence: TAS. Frequency: Frequent (HP:0040282). (ORPHA:238722)
- Abnormal corticospinal tract morphology (HP:0002492): Abnormality of the corticospinal tract, which is the chief element of the pyramidal system (the principle motor tract) and is the only direct connection between the cerebrum and the spinal cord. Evidence: TAS. Frequency: Frequent (HP:0040282). (ORPHA:238722)
- Easy fatigability (HP:0003388): Increased susceptibility to fatigue. Evidence: TAS. Frequency: Frequent (HP:0040282). (ORPHA:238722)
- Poor fine motor coordination (HP:0007010): An abnormality of the ability (skills) to perform a precise movement of small muscles with the intent to perform a specific act. Fine motor skills are required to mediate movements of the wrists, hands, fingers, feet, and toes. Evidence: TAS. Frequency: Frequent (HP:0040282). (ORPHA:238722)
- Abnormality of movement (HP:0100022): An abnormality of movement with a neurological basis characterized by changes in coordination and speed of voluntary movements. Evidence: TAS. Frequency: Frequent (HP:0040282). (ORPHA:238722)
- Agenesis of corpus callosum (HP:0001274): Absence of the corpus callosum as a result of the failure of the corpus callosum to develop, which can be the result of a failure in any one of the multiple steps of callosal development including cellular proliferation and migration, axonal growth or glial patterning at the midline. Evidence: TAS. Frequency: Occasional (HP:0040283). (ORPHA:238722)
- Specific learning disability (HP:0001328): Impairment of certain skills such as reading or writing, coordination, self-control, or attention that interfere with the ability to learn. The impairment is not related to a global deficiency of intelligence. Evidence: TAS. Frequency: Occasional (HP:0040283). (ORPHA:238722)
- Myalgia (HP:0003326): Pain in muscle. Evidence: TAS. Frequency: Occasional (HP:0040283). (ORPHA:238722)
- Dysgenesis of the hippocampus (HP:0025101): Structural abnormality of the hippocampus related to defective development. Evidence: TAS. Frequency: Occasional (HP:0040283). (ORPHA:238722)
- Hypogonadotropic hypogonadism (HP:0000044): Hypogonadotropic hypogonadism is characterized by reduced function of the gonads (testes in males or ovaries in females) and results from the absence of the gonadal stimulating pituitary hormones: follicle stimulating hormone (FSH) and luteinizing hormone (LH). Evidence: TAS. Frequency: Very rare (HP:0040284). (ORPHA:238722)
- Mild intellectual disability (HP:0001256): Mild intellectual disability (ID) is defined as a type of ID characterized by mildly sub-average adaptive functioning and intellectual functioning, with an intelligence quotient (IQ) the range of 50-69. Evidence: TAS. Frequency: Very rare (HP:0040284). (ORPHA:238722)
- Fused cervical vertebrae (HP:0002949): A congenital anomaly characterized by a joining (fusion) of two or more cervical vertebral bodies with one another. Evidence: TAS. Frequency: Very rare (HP:0040284). (ORPHA:238722)
- Cerebral palsy (HP:0100021): Cerebral palsy describes a group of permanent disorders of the development of movement and posture, causing activity limitation, that are attributed to nonprogressive disturbances that occurred in the developing fetal or infant brain. The motor disorders of cerebral palsy are often accompanied by disturbances of sensation, perception, cognition, communication, and behavior, by epilepsy, and by secondary musculoskeletal problems. Evidence: TAS. Frequency: Very rare (HP:0040284). (ORPHA:238722)
These phenotypes are associated with the disease Familial congenital mirror movements (ORPHA:238722).